Phenotypes associated with the disease neurodevelopmental disorder with microcephaly, short stature, and speech delay (OMIM:620027):
- Poor speech (HP:0002465). Evidence: PCS. Frequency: 1/2. (PMID:30167849)
- Microcephaly (HP:0000252): Head circumference below 2 standard deviations below the mean for age and gender. Evidence: PCS. Frequency: 7/8. (PMID:35298461)
- Upslanted palpebral fissure (HP:0000582): The palpebral fissure inclination is more than two standard deviations above the mean for age (objective); or, the inclination of the palpebral fissure is greater than typical for age. Evidence: PCS. (PMID:35298461)
- Delayed speech and language development (HP:0000750): A degree of language development that is significantly below the norm for a child of a specified age. Evidence: PCS. Frequency: 8/8. (PMID:35298461)
- Absent speech (HP:0001344): Complete lack of development of speech and language abilities. Evidence: PCS. Frequency: 3/8. (PMID:35298461)
- Delayed ability to walk (HP:0031936): A failure to achieve the ability to walk at an appropriate developmental stage. Most children learn to walk in a series of stages, and learn to walk short distances independently between 12 and 15 months. Evidence: PCS. Frequency: 8/8. (PMID:35298461)
- Short stature (HP:0004322): A height below that which is expected according to age and gender norms. Although there is no universally accepted definition of short stature, many refer to "short stature" as height more than 2 standard deviations below the mean for age and gender (or below the 3rd percentile for age and gender dependent norms). Evidence: PCS. (PMID:35298461)
- Seizure (HP:0001250): A seizure is an intermittent abnormality of nervous system physiology characterized by a transient occurrence of signs and/or symptoms due to abnormal excessive or synchronous neuronal activity in the brain. Evidence: PCS. Frequency: 4/8. (PMID:35298461)
- Global developmental delay (HP:0001263): A delay in the achievement of motor or mental milestones in the domains of development of a child, including motor skills, speech and language, cognitive skills, and social and emotional skills. This term should only be used to describe children younger than five years of age. Evidence: PCS. Frequency: 8/8. (PMID:35298461)
- Hypotonia (HP:0001252): Hypotonia is an abnormally low muscle tone (the amount of tension or resistance to movement in a muscle). Even when relaxed, muscles have a continuous and passive partial contraction which provides some resistance to passive stretching. Hypotonia thus manifests as diminished resistance to passive stretching. Hypotonia is not the same as muscle weakness, although the two conditions can co-exist. Evidence: PCS. Frequency: 8/8. (PMID:35298461)
- Severe intellectual disability (HP:0010864): Severe intellectual disability (ID) is defined as a type of ID characterized by severely sub-average adaptive functioning and intellectual functioning, with an intelligence quotient (IQ) the range of 20-34. Evidence: PCS. Frequency: 10/10. (PMID:35298461;PMID:30167849)
- Childhood onset (HP:0011463): Onset of disease at the age of between 1 and 5 years. Evidence: PCS. Frequency: 8/8. (PMID:35298461)
- Aggressive behavior (HP:0000718): Behavior or an act aimed at harming a person, animal, or physical property (e.g., acts of physical violence; shouting, swearing, and using harsh language; slashing someone's tires). Evidence: PCS. Frequency: 1/2. (PMID:30167849)
- Autosomal recessive inheritance (HP:0000007): A mode of inheritance that is observed for traits related to a gene encoded on one of the autosomes (i.e., the human chromosomes 1-22) in which a trait manifests in individuals with two pathogenic alleles, either homozygotes (two copies of the same mutant allele) or compound heterozygotes (whereby each copy of a gene has a distinct mutant allele). Evidence: PCS. (PMID:30167849)
- Waddling gait (HP:0002515): Weakness of the hip girdle and upper thigh muscles, for instance in myopathies, leads to an instability of the pelvis on standing and walking. If the muscles extending the hip joint are affected, the posture in that joint becomes flexed and lumbar lordosis increases. The patients usually have difficulties standing up from a sitting position. Due to weakness in the gluteus medius muscle, the hip on the side of the swinging leg drops with each step (referred to as Trendelenburg sign). The gait appears waddling. The patients frequently attempt to counteract the dropping of the hip on the swinging side by bending the trunk towards the side which is in the stance phase (in the German language literature this is referred to as Duchenne sign). Similar gait patterns can be caused by orthopedic conditions when the origin and the insertion site of the gluteus medius muscle are closer to each other than normal, for instance due to a posttraumatic elevation of the trochanter or pseudarthrosis of the femoral neck. Evidence: PCS. Frequency: 3/8. (PMID:35298461)
- Synophrys (HP:0000664): Meeting of the medial eyebrows in the midline. Evidence: PCS. (PMID:35298461)